Phenotypes associated with the disease cone-rod dystrophy 1 (OMIM:600624):
- Juvenile onset (HP:0003621): Onset of signs or symptoms of disease between the age of 5 and 15 years. Evidence: IEA. (OMIM:600624)
- Hearing impairment (HP:0000365): A decreased magnitude of the sensory perception of sound. Evidence: IEA. (OMIM:600624)
- Childhood onset (HP:0011463): Onset of disease at the age of between 1 and 5 years. Evidence: TAS. (OMIM:600624)
- Cone/cone-rod dystrophy (HP:0000548). Evidence: IEA. (OMIM:600624)
- Abnormality of the ear (HP:0000598): An abnormality of the ear. Evidence: IEA. (OMIM:600624)
- Hypogonadism (HP:0000135): A decreased functionality of the gonad. Evidence: IEA. (OMIM:600624)
- Autosomal dominant inheritance (HP:0000006): A mode of inheritance that is observed for traits related to a gene encoded on one of the autosomes (i.e., the human chromosomes 1-22) in which a trait manifests in heterozygotes. In the context of medical genetics, an autosomal dominant disorder is caused when a single copy of the mutant allele is present. Males and females are affected equally, and can both transmit the disorder with a risk of 50% for each child of inheriting the mutant allele. Evidence: IEA. (OMIM:600624)
- Intellectual disability (HP:0001249): The term intellectual disability or intellectual developmental disorder is used to describe significantly sub-average intellectual and adaptive functioning based on clinical assessment and as measured by individually administered, appropriately normed, standardized and validated tests of intellectual functioning and adaptive behavior, with onset during the developmental period from infancy through adolescence. Evidence: IEA. (OMIM:600624)